- Respiratory distress (HP:0002098): Respiratory distress is objectively observable as the physical or emotional consequences from the experience of dyspnea. The physical presentation of respiratory distress is generally referred to as labored breathing, while the sensation of respiratory distress is called shortness of breath or dyspnea. Evidence: IEA. (OMIM:600335)
- Autosomal recessive inheritance (HP:0000007): A mode of inheritance that is observed for traits related to a gene encoded on one of the autosomes (i.e., the human chromosomes 1-22) in which a trait manifests in individuals with two pathogenic alleles, either homozygotes (two copies of the same mutant allele) or compound heterozygotes (whereby each copy of a gene has a distinct mutant allele). Evidence: IEA. (OMIM:600335)
- Lactic acidosis (HP:0003128): An abnormal buildup of lactic acid in the body, leading to acidification of the blood and other bodily fluids. Evidence: IEA. (OMIM:600335)
These phenotypes are associated with the disease succinic acidemia (OMIM:600335).